- Poor speech (HP:0002465). Evidence: PCS. (PMID:27123486)
- Global developmental delay (HP:0001263): A delay in the achievement of motor or mental milestones in the domains of development of a child, including motor skills, speech and language, cognitive skills, and social and emotional skills. This term should only be used to describe children younger than five years of age. Evidence: PCS. (PMID:27123486)
- Chorea (HP:0002072): Chorea (Greek for 'dance') refers to widespread arrhythmic involuntary movements of a forcible, jerky and restless fashion. It is a random-appearing sequence of one or more discrete involuntary movements or movement fragments. Movements appear random because of variability in timing, duration or location. Each movement may have a distinct start and end. However, movements may be strung together and thus may appear to flow randomly from one muscle group to another. Chorea can involve the trunk, neck, face, tongue, and extremities. Evidence: PCS. (PMID:27123486)
- Autosomal recessive inheritance (HP:0000007): A mode of inheritance that is observed for traits related to a gene encoded on one of the autosomes (i.e., the human chromosomes 1-22) in which a trait manifests in individuals with two pathogenic alleles, either homozygotes (two copies of the same mutant allele) or compound heterozygotes (whereby each copy of a gene has a distinct mutant allele). Evidence: PCS. (PMID:27123486)
- Involuntary movements (HP:0004305): Involuntary contractions of muscle leading to involuntary movements of extremities, neck, trunk, or face. Evidence: PCS. (PMID:27123486)
- Intellectual disability (HP:0001249): The term intellectual disability or intellectual developmental disorder is used to describe significantly sub-average intellectual and adaptive functioning based on clinical assessment and as measured by individually administered, appropriately normed, standardized and validated tests of intellectual functioning and adaptive behavior, with onset during the developmental period from infancy through adolescence. Evidence: TAS. (OMIM:616939)
- Abnormal head movements (HP:0002457). Evidence: PCS. (PMID:27123486)
These phenotypes are associated with the disease chorea, childhood-onset, with psychomotor retardation (OMIM:616939).